- Microcephaly (HP:0000252): Head circumference below 2 standard deviations below the mean for age and gender. Evidence: IEA. (DECIPHER:2)
- Abnormally high-pitched voice (HP:0001620): A persistent (minutes to hours) abnormal increase in the pitch (frequency) of the voice for the context or social situation or significantly different from baseline of the individual. Evidence: IEA. (DECIPHER:2)
- Intellectual disability (HP:0001249): The term intellectual disability or intellectual developmental disorder is used to describe significantly sub-average intellectual and adaptive functioning based on clinical assessment and as measured by individually administered, appropriately normed, standardized and validated tests of intellectual functioning and adaptive behavior, with onset during the developmental period from infancy through adolescence. Evidence: IEA. (DECIPHER:2)
These phenotypes are associated with the disease Cri-du-chat syndrome (DECIPHER:2).